Phenotypes associated with the disease Autosomal recessive spastic paraplegia type 39 (ORPHA:139480):
- Spastic paraplegia (HP:0001258): Complete loss of the ability to move the lower limbs accompanied by spasticity of the lower limbs. Evidence: TAS. Frequency: Frequent (HP:0040282). (ORPHA:139480)
- Hyperreflexia (HP:0001347): Hyperreflexia is the presence of hyperactive stretch reflexes of the muscles. Evidence: TAS. Frequency: Frequent (HP:0040282). (ORPHA:139480)
- Lower limb spasticity (HP:0002061): Spasticity (velocity-dependent increase in tonic stretch reflexes with increased muscle tone and hyperexcitable tendon reflexes) in the muscles of the lower limbs, hips, and pelvis. Evidence: TAS. Frequency: Frequent (HP:0040282). (ORPHA:139480)
- Babinski sign (HP:0003487): Upturning of the big toe (and sometimes fanning of the other toes) in response to stimulation of the sole of the foot. If the Babinski sign is present it can indicate damage to the corticospinal tract. Evidence: TAS. Frequency: Frequent (HP:0040282). (ORPHA:139480)
- Atrophy of the spinal cord (HP:0006827). Evidence: TAS. Frequency: Frequent (HP:0040282). (ORPHA:139480)
- Motor axonal neuropathy (HP:0007002): Progressive impairment of function of motor axons with muscle weakness, atrophy, and cramps. The deficits are length-dependent, meaning that muscles innervated by the longest nerves are affected first, so that for instance the arms are affected at a later age than the onset of deficits involving the lower leg. Evidence: TAS. Frequency: Frequent (HP:0040282). (ORPHA:139480)
- Generalized limb muscle atrophy (HP:0009055): Generalized (unlocalized) atrophy affecting muscles of the limbs in both proximal and distal locations. Evidence: TAS. Frequency: Frequent (HP:0040282). (ORPHA:139480)
- Cerebellar atrophy (HP:0001272): Cerebellar atrophy is defined as a cerebellum with initially normal structures, in a posterior fossa with normal size, which displays enlarged fissures (interfolial spaces) in comparison to the foliae secondary to loss of tissue. Cerebellar atrophy implies irreversible loss of tissue and result from an ongoing progressive disease until a final stage is reached or a single injury, e.g. an intoxication or infectious event. Evidence: TAS. Frequency: Occasional (HP:0040283). (ORPHA:139480)
- Gait ataxia (HP:0002066): A type of ataxia characterized by the impairment of the ability to coordinate the movements required for normal walking. Gait ataxia is characteirzed by a wide-based staggering gait with a tendency to fall. Evidence: TAS. Frequency: Occasional (HP:0040283). (ORPHA:139480)